Phenotypes associated with the disease Plague (ORPHA:707):
- Fever (HP:0001945): Body temperature elevated above the normal range. Evidence: TAS. Frequency: Very frequent (HP:0040281). (ORPHA:707)
- Lymphadenitis (HP:0002840): Inflammation of a lymph node. Evidence: TAS. Frequency: Very frequent (HP:0040281). (ORPHA:707)
- Fatigue (HP:0012378): A subjective feeling of tiredness characterized by a lack of energy and motivation. Evidence: TAS. Frequency: Very frequent (HP:0040281). (ORPHA:707)
- Anxiety (HP:0000739): Intense feelings of nervousness, tension, or panic often arise in response to interpersonal stresses. There is worry about the negative effects of past unpleasant experiences and future negative possibilities. Individuals may feel fearful, apprehensive, or threatened by uncertainty, and they may also have fears of falling apart or losing control. Evidence: TAS. Frequency: Frequent (HP:0040282). (ORPHA:707)
- Dry skin (HP:0000958): Skin characterized by the lack of natural or normal moisture. Evidence: TAS. Frequency: Frequent (HP:0040282). (ORPHA:707)
- Tachycardia (HP:0001649): A rapid heartrate that exceeds the range of the normal resting heartrate for age. Evidence: TAS. Frequency: Frequent (HP:0040282). (ORPHA:707)
- Splenomegaly (HP:0001744): Abnormal increased size of the spleen. Evidence: TAS. Frequency: Frequent (HP:0040282). (ORPHA:707)
- Anorexia (HP:0002039): Lack of desire to eat (loss of appetite). Evidence: TAS. Frequency: Frequent (HP:0040282). (ORPHA:707)
- Hepatomegaly (HP:0002240): Abnormally increased size of the liver. Evidence: TAS. Frequency: Frequent (HP:0040282). (ORPHA:707)
- Headache (HP:0002315): Cephalgia, or pain sensed in various parts of the head, not confined to the area of distribution of any nerve. Evidence: TAS. Frequency: Frequent (HP:0040282). (ORPHA:707)
- Reduced consciousness (HP:0004372): Abnormally diminished level of attention, responsiveness, or wakefulness. Evidence: TAS. Frequency: Frequent (HP:0040282). (ORPHA:707)
- Abnormal blistering of the skin (HP:0008066): The presence of one or more bullae on the skin, defined as fluid-filled blisters more than 5 mm in diameter with thin walls. Evidence: TAS. Frequency: Frequent (HP:0040282). (ORPHA:707)
- Localized skin lesion (HP:0011355): A lesion of the skin that is located in a specific region rather than being generalized. Evidence: TAS. Frequency: Frequent (HP:0040282). (ORPHA:707)
- Carbuncle (HP:0020084): A pustular lesion of the skin emerging from group of infected hair follicles, characterized by a deep location and dissecting through tissue planes. A carbuncle is larger and deeper than a furuncle. Evidence: TAS. Frequency: Frequent (HP:0040282). (ORPHA:707)
- Chills (HP:0025143): A sudden sensation of feeling cold. Evidence: TAS. Frequency: Frequent (HP:0040282). (ORPHA:707)
- Conjunctival hyperemia (HP:0030953): Dilatation of the blood vessels of the conjunctiva leading to a red appearance of the sclera. Evidence: TAS. Frequency: Frequent (HP:0040282). (ORPHA:707)
- Delirium (HP:0031258): A state of sudden and severe confusion. Evidence: TAS. Frequency: Frequent (HP:0040282). (ORPHA:707)
- Bacteremia (HP:0031864): Presence of viable bacteria in the blood. Evidence: TAS. Frequency: Frequent (HP:0040282). (ORPHA:707)
- Chest pain (HP:0100749): An unpleasant sensation characterized by physical discomfort (such as pricking, throbbing, or aching) localized to the chest. Evidence: TAS. Frequency: Frequent (HP:0040282). (ORPHA:707)
- Skin ulcer (HP:0200042): A discontinuity of the skin exhibiting complete loss of the epidermis and often portions of the dermis and even subcutaneous fat. Evidence: TAS. Frequency: Frequent (HP:0040282). (ORPHA:707)
- Glossitis (HP:0000206): Inflammation of the tongue. Evidence: TAS. Frequency: Occasional (HP:0040283). (ORPHA:707)
- Hearing impairment (HP:0000365): A decreased magnitude of the sensory perception of sound. Evidence: TAS. Frequency: Occasional (HP:0040283). (ORPHA:707)
- Depression (HP:0000716): Frequently experiencing feelings of being down, miserable, and/or hopeless; struggling to recover from these moods; having a pessimistic outlook on the future; feeling a pervasive sense of shame; having a low self-worth; experiencing thoughts of suicide and engaging in suicidal behavior. Evidence: TAS. Frequency: Occasional (HP:0040283). (ORPHA:707)
- Edema (HP:0000969): An abnormal accumulation of fluid beneath the skin, or in one or more cavities of the body. Evidence: TAS. Frequency: Occasional (HP:0040283). (ORPHA:707)
- Skin rash (HP:0000988): A red eruption of the skin. Evidence: TAS. Frequency: Occasional (HP:0040283). (ORPHA:707)
- Coma (HP:0001259): The complete absence of wakefulness and consciousness, which is evident through a lack of response to any form of external stimuli. Evidence: TAS. Frequency: Occasional (HP:0040283). (ORPHA:707)
- Slurred speech (HP:0001350): Abnormal coordination of muscles involved in speech. Evidence: TAS. Frequency: Occasional (HP:0040283). (ORPHA:707)
- Abnormal bleeding (HP:0001892): An abnormal susceptibility to bleeding, often referred to as a bleeding diathesis. A bleeding diathesis may be related to vascular, platelet and coagulation defects. Evidence: TAS. Frequency: Occasional (HP:0040283). (ORPHA:707)
- Vomiting (HP:0002013): Forceful ejection of the contents of the stomach through the mouth by means of a series of involuntary spasmic contractions. Evidence: TAS. Frequency: Occasional (HP:0040283). (ORPHA:707)
- Diarrhea (HP:0002014): Abnormally increased frequency (usually defined as three or more) loose or watery bowel movements a day. Evidence: TAS. Frequency: Occasional (HP:0040283). (ORPHA:707)
- Abdominal pain (HP:0002027): An unpleasant sensation characterized by physical discomfort (such as pricking, throbbing, or aching) and perceived to originate in the abdomen. Evidence: TAS. Frequency: Occasional (HP:0040283). (ORPHA:707)
- Inflammation of the large intestine (HP:0002037): Inflammation, or an inflammatory state in the large intestine. Evidence: TAS. Frequency: Occasional (HP:0040283). (ORPHA:707)
- Respiratory distress (HP:0002098): Respiratory distress is objectively observable as the physical or emotional consequences from the experience of dyspnea. The physical presentation of respiratory distress is generally referred to as labored breathing, while the sensation of respiratory distress is called shortness of breath or dyspnea. Evidence: TAS. Frequency: Occasional (HP:0040283). (ORPHA:707)
- Hemoptysis (HP:0002105): Coughing up (expectoration) of blood or blood-streaked sputum from the larynx, trachea, bronchi, or lungs. Evidence: TAS. Frequency: Occasional (HP:0040283). (ORPHA:707)
- Hematemesis (HP:0002248): The vomiting of blood. Evidence: TAS. Frequency: Occasional (HP:0040283). (ORPHA:707)
- Unsteady gait (HP:0002317). Evidence: TAS. Frequency: Occasional (HP:0040283). (ORPHA:707)
- Hypotension (HP:0002615): Low Blood Pressure, vascular hypotension. Evidence: TAS. Frequency: Occasional (HP:0040283). (ORPHA:707)
- Arthralgia (HP:0002829): Joint pain. Evidence: TAS. Frequency: Occasional (HP:0040283). (ORPHA:707)
- Enterocolitis (HP:0004387): An inflammation of the colon and small intestine. However, most conditions are either categorized as Enteritis (inflammation of the small intestine) or Colitis (inflammation of the large intestine). Evidence: TAS. Frequency: Occasional (HP:0040283). (ORPHA:707)
- Abnormality of the elbow (HP:0009811): An anomaly of the joint that connects the upper and the lower arm. Evidence: TAS. Frequency: Occasional (HP:0040283). (ORPHA:707)
- Mydriasis (HP:0011499): Abnormal dilatation of the iris. Evidence: TAS. Frequency: Occasional (HP:0040283). (ORPHA:707)
- Arrhythmia (HP:0011675): Any cardiac rhythm other than the normal sinus rhythm. Such a rhythm may be either of sinus or ectopic origin and either regular or irregular. An arrhythmia may be due to a disturbance in impulse formation or conduction or both. Evidence: TAS. Frequency: Occasional (HP:0040283). (ORPHA:707)
- Acute infectious pneumonia (HP:0011949): Acute inflammation of the lung due to an infection. Evidence: TAS. Frequency: Occasional (HP:0040283). (ORPHA:707)
- Erythema nodosum (HP:0012219): An erythematous eruption commonly associated with drug reactions or infection and characterized by inflammatory nodules that are usually tender, multiple, and bilateral. Evidence: TAS. Frequency: Occasional (HP:0040283). (ORPHA:707)
- Enlarged mesenteric lymph node (HP:0025043): Increase in size of one or more mesenteric lymph nodes. Evidence: TAS. Frequency: Occasional (HP:0040283). (ORPHA:707)
- Bloody diarrhea (HP:0025085): Passage of many stools containing blood. Evidence: TAS. Frequency: Occasional (HP:0040283). (ORPHA:707)
- Ileitis (HP:0032564): Inflammation of the ileum. Evidence: TAS. Frequency: Occasional (HP:0040283). (ORPHA:707)
- Chapped lip (HP:0040181): Cracking, fissuring, and peeling of the skin of the lips. Evidence: TAS. Frequency: Occasional (HP:0040283). (ORPHA:707)
- Sepsis (HP:0100806): Sepsis is defined as life-threatening organ dysfunction caused by a dysregulated host response to infection. Evidence: TAS. Frequency: Occasional (HP:0040283). (ORPHA:707)
- Meningitis (HP:0001287): Inflammation of the meninges. Evidence: TAS. Frequency: Very rare (HP:0040284). (ORPHA:707)
- Muscle weakness (HP:0001324): Reduced strength of muscles. Evidence: TAS. Frequency: Very rare (HP:0040284). (ORPHA:707)
- Arthritis (HP:0001369): Inflammation of a joint. Evidence: TAS. Frequency: Very rare (HP:0040284). (ORPHA:707)
- Pharyngitis (HP:0025439): Inflammation (due to infection or irritation) of the pharynx. Evidence: TAS. Frequency: Very rare (HP:0040284). (ORPHA:707)
- Inflammatory abnormality of the eye (HP:0100533): Inflammation of the eye, parts of the eye or the periorbital region. Evidence: TAS. Frequency: Very rare (HP:0040284). (ORPHA:707)
- Endocarditis (HP:0100584): An inflammation of the endocardium, the inner layer of the heart, which usually involves the heart valves. Evidence: TAS. Frequency: Very rare (HP:0040284). (ORPHA:707)